Phenotypes associated with the disease hypospadias 2, X-linked (OMIM:300758):
- Penoscrotal hypospadias (HP:0000808): A severe form of hypospadias in which the urethral opening is located at the junction of the penis and scrotum. Evidence: PCS. Frequency: 4/4. (PMID:17086185)
- Congenital onset (HP:0003577): A phenotypic abnormality that is present at birth. Evidence: PCS. Frequency: 4/4. (PMID:17086185)
- X-linked recessive inheritance (HP:0001419): A mode of inheritance that is observed for recessive traits related to a gene encoded on the X chromosome. In the context of medical genetics, X-linked recessive disorders manifest in males (who have one copy of the X chromosome and are thus hemizygotes), but generally not in female heterozygotes who have one mutant and one normal allele. Evidence: PCS. (PMID:17086185)